- Glomerulonephritis (HP:0000099): Inflammation of the renal glomeruli. Evidence: TAS. (OMIM:174770)
- Cutaneous photosensitivity (HP:0000992): An increased sensitivity of the skin to light. Photosensitivity may result in a rash upon exposure to the sun (which is known as photodermatosis). Photosensitivity can be diagnosed by phototests in which light is shone on small areas of skin. Evidence: TAS. (OMIM:174770)
- Cheilitis (HP:0100825): Inflammation of the lip. Evidence: TAS. (OMIM:174770)
- Pyoderma (HP:0000999): Any manifestation of a skin disease associated with the production of pus. Evidence: TAS. (OMIM:174770)
- Autosomal dominant inheritance (HP:0000006): A mode of inheritance that is observed for traits related to a gene encoded on one of the autosomes (i.e., the human chromosomes 1-22) in which a trait manifests in heterozygotes. In the context of medical genetics, an autosomal dominant disorder is caused when a single copy of the mutant allele is present. Males and females are affected equally, and can both transmit the disorder with a risk of 50% for each child of inheriting the mutant allele. Evidence: IEA. (OMIM:174770)
These phenotypes are associated with the disease actinic prurigo (OMIM:174770).